Phenotypes associated with the disease Delayed encephalopathy due to carbon monoxide poisoning (ORPHA:306686):
- Atypical behavior (HP:0000708): Atypical behavior is an abnormality in a person's actions that can be controlled or modulated by the will of the individual. While abnormal behaviors can be difficult to control, they are distinct from other abnormal actions that cannot be affected by the individual's will. Evidence: TAS. Frequency: Very frequent (HP:0040281). (ORPHA:306686)
- Memory impairment (HP:0002354): An impairment of memory as manifested by a reduced ability to remember things such as dates and names, and increased forgetfulness. Evidence: TAS. Frequency: Very frequent (HP:0040281). (ORPHA:306686)
- Abnormal periventricular white matter morphology (HP:0002518): A structural abnormality of the myelinated axons (white matter) located near the cerebral ventricles. Evidence: TAS. Frequency: Very frequent (HP:0040281). (ORPHA:306686)
- Elevated brain choline level by MRS (HP:0012706): An increase in the level of choline-containing compounds in the brain identified by magnetic resonance spectroscopy (MRS). Evidence: TAS. Frequency: Very frequent (HP:0040281). (ORPHA:306686)
- Reduced brain N-acetyl aspartate level by MRS (HP:0012708): A decrease in the level of N-acetyl aspartate in the brain identified by magnetic resonance spectroscopy (MRS). Evidence: TAS. Frequency: Very frequent (HP:0040281). (ORPHA:306686)
- Rigidity (HP:0002063): Continuous involuntary sustained muscle contraction. When an affected muscle is passively stretched, the degree of resistance remains constant regardless of the rate at which the muscle is stretched. This feature helps to distinguish rigidity from muscle spasticity. Evidence: TAS. Frequency: Frequent (HP:0040282). (ORPHA:306686)
- Bradykinesia (HP:0002067): Bradykinesia literally means slow movement, and is used clinically to denote a slowness in the execution of movement (in contrast to hypokinesia, which is used to refer to slowness in the initiation of movement). Evidence: TAS. Frequency: Frequent (HP:0040282). (ORPHA:306686)
- Abnormality of the upper limb (HP:0002817): An abnormality of the arm. Evidence: TAS. Frequency: Frequent (HP:0040282). (ORPHA:306686)
- Decreased facial expression (HP:0004673): A reduced degree of voluntary and involuntary facial movements involved in responded to others or expressing emotions. Evidence: TAS. Frequency: Frequent (HP:0040282). (ORPHA:306686)